- High hypermetropia (HP:0008499): A severe form of hypermetropia with over +5.00 diopters. Evidence: TAS. (OMIM:238950)
- Autosomal recessive inheritance (HP:0000007): A mode of inheritance that is observed for traits related to a gene encoded on one of the autosomes (i.e., the human chromosomes 1-22) in which a trait manifests in individuals with two pathogenic alleles, either homozygotes (two copies of the same mutant allele) or compound heterozygotes (whereby each copy of a gene has a distinct mutant allele). Evidence: TAS. (OMIM:238950)
These phenotypes are associated with the disease hyperopia, high (OMIM:238950).